- EEG with spike-wave complexes (>3.5 Hz) (HP:0010849): The presence of complexes of spikes and waves (>3.5 Hz) in electroencephalography (EEG). Evidence: TAS. (OMIM:611634)
- Febrile seizure (within the age range of 3 months to 6 years) (HP:0002373): A febrile seizure is any type of seizure (most often a generalized tonic-clonic seizure) occurring with fever (at least 38 degrees Celsius) but in the absence of central nervous system infection, severe metabolic disturbance or other alternative precipitant in children between the ages of 3 months and 6 years. Evidence: IEA. (OMIM:611634)
- Generalized non-motor (absence) seizure (HP:0002121): A generalized non-motor (absence) seizure is a type of a type of dialeptic seizure that is of electrographically generalized onset. It is a generalized seizure characterized by an interruption of activities, a blank stare, and usually the person will be unresponsive when spoken to. Any ictal motor phenomena are minor in comparison to these non-motor features. Evidence: TAS. (OMIM:611634)
- Autosomal dominant inheritance (HP:0000006): A mode of inheritance that is observed for traits related to a gene encoded on one of the autosomes (i.e., the human chromosomes 1-22) in which a trait manifests in heterozygotes. In the context of medical genetics, an autosomal dominant disorder is caused when a single copy of the mutant allele is present. Males and females are affected equally, and can both transmit the disorder with a risk of 50% for each child of inheriting the mutant allele. Evidence: IEA. (OMIM:611634)
These phenotypes are associated with the disease familial febrile seizures 9 (OMIM:611634).